Phenotypes associated with the disease spermatogenic failure 93 (OMIM:620849):
- Irregularly shaped sperm tail (HP:0033393): Irregular or changing caliber (diameter) along the tail of the sperm. Evidence: PCS. Frequency: 3/3. (PMID:34155512)
- Reduced progressive sperm motility (HP:0034011): A reduced proportion of sperm that move in a straight line or large circles; alternatively, an increased proportion of sperm that move in tight circles or in some other non-linear fashion. Evidence: PCS. Frequency: 4/4. (PMID:34155512)
- Coiled sperm flagella (HP:0032560): Sperm cells whose flagella are twisted (coiled). Evidence: PCS. Frequency: 3/3. (PMID:34155512)
- Male infertility (HP:0003251). Evidence: PCS. Frequency: 4/4. (PMID:34155512)
- Young adult onset (HP:0011462): Onset of disease at the age of between 16 and 40 years. Evidence: PCS. Frequency: 4/4. (PMID:34155512)
- Reduced sperm motility (HP:0012207): An abnormal reduction in the mobility of ejaculated sperm. Evidence: PCS. Frequency: 3/4. (PMID:34155512)
- Autosomal recessive inheritance (HP:0000007): A mode of inheritance that is observed for traits related to a gene encoded on one of the autosomes (i.e., the human chromosomes 1-22) in which a trait manifests in individuals with two pathogenic alleles, either homozygotes (two copies of the same mutant allele) or compound heterozygotes (whereby each copy of a gene has a distinct mutant allele). Evidence: PCS. (PMID:34155512)
- Bent sperm flagella (HP:0034811): The proportion of sperm cells whose flagella is sharply curved or has a sharp angle is above normal limits. Evidence: PCS. Frequency: 3/3. (PMID:34155512)
- Oligozoospermia (HP:0000798): Reduced count of spermatozoa in the semen, defined as a sperm count below 20 million per milliliter semen. Evidence: PCS. Frequency: 1/4. (PMID:34155512)
- Absent sperm flagella (HP:0032558): Sperm cells lacking flagella. Evidence: PCS. Frequency: 3/3. (PMID:34155512)
- Short sperm flagella (HP:0032559): Sperm cells with abnormally short flagella. Evidence: PCS. Frequency: 3/3. (PMID:34155512)